Phenotypes associated with the disease Enteric anendocrinosis (ORPHA:83620):
- Dehydration (HP:0001944). Evidence: TAS. Frequency: Very frequent (HP:0040281). (ORPHA:83620)
- Vomiting (HP:0002013): Forceful ejection of the contents of the stomach through the mouth by means of a series of involuntary spasmic contractions. Evidence: TAS. Frequency: Very frequent (HP:0040281). (ORPHA:83620)
- Diarrhea (HP:0002014): Abnormally increased frequency (usually defined as three or more) loose or watery bowel movements a day. Evidence: TAS. Frequency: Very frequent (HP:0040281). (ORPHA:83620)
- Malabsorption (HP:0002024): Impaired ability to absorb one or more nutrients from the intestine. Evidence: TAS. Frequency: Very frequent (HP:0040281). (ORPHA:83620)
- Hyperchloremic metabolic acidosis (HP:0004918): A form of metabolic acidosis with increased serum chloride levels. Evidence: TAS. Frequency: Very frequent (HP:0040281). (ORPHA:83620)
- Portal hypertension (HP:0001409): Increased pressure in the portal vein. Evidence: TAS. Frequency: Frequent (HP:0040282). (ORPHA:83620)
- Cholestatic liver disease (HP:0002611). Evidence: TAS. Frequency: Frequent (HP:0040282). (ORPHA:83620)
- Abnormal cellular phenotype (HP:0025354): An anomaly of cellular morphology or physiology. Evidence: TAS. Frequency: Frequent (HP:0040282). (ORPHA:83620)
- Type I diabetes mellitus (HP:0100651): A chronic condition in which the pancreas produces little or no insulin. Type I diabetes mellitus is manifested by the sudden onset of severe hyperglycemia with rapid progression to diabetic ketoacidosis unless treated with insulin. Evidence: TAS. Frequency: Frequent (HP:0040282). (ORPHA:83620)